Phenotypes associated with the disease Parkinson disease 21 (OMIM:616361):
- Lewy bodies (HP:0100315). Evidence: TAS. (OMIM:616361)
- Bradykinesia (HP:0002067): Bradykinesia literally means slow movement, and is used clinically to denote a slowness in the execution of movement (in contrast to hypokinesia, which is used to refer to slowness in the initiation of movement). Evidence: TAS. (OMIM:616361)
- Parkinsonism (HP:0001300): Characteristic neurologic anomaly resulting from degeneration of dopamine-generating cells in the substantia nigra, a region of the midbrain, characterized clinically by shaking, rigidity, slowness of movement and difficulty with walking and gait. Evidence: TAS. (OMIM:616361)
- Rigidity (HP:0002063): Continuous involuntary sustained muscle contraction. When an affected muscle is passively stretched, the degree of resistance remains constant regardless of the rate at which the muscle is stretched. This feature helps to distinguish rigidity from muscle spasticity. Evidence: TAS. (OMIM:616361)
- Postural instability (HP:0002172): A tendency to fall or the inability to keep oneself from falling; imbalance. The retropulsion test is widely regarded as the gold standard to evaluate postural instability, Use of the retropulsion test includes a rapid balance perturbation in the backward direction, and the number of balance correcting steps (or total absence thereof) is used to rate the degree of postural instability. Healthy subjects correct such perturbations with either one or two large steps, or without taking any steps, hinging rapidly at the hips while swinging the arms forward as a counterweight. In patients with balance impairment, balance correcting steps are often too small, forcing patients to take more than two steps. Taking three or more steps is generally considered to be abnormal, and taking more than five steps is regarded as being clearly abnormal. Markedly affected patients continue to step backward without ever regaining their balance and must be caught by the examiner (this would be called true retropulsion). Even more severely affected patients fail to correct entirely, and fall backward like a pushed toy soldier, without taking any corrective steps. Evidence: TAS. (OMIM:616361)
- Tremor (HP:0001337): An unintentional, oscillating to-and-fro muscle movement about a joint axis. Evidence: TAS. (OMIM:616361)
- Autosomal dominant inheritance (HP:0000006): A mode of inheritance that is observed for traits related to a gene encoded on one of the autosomes (i.e., the human chromosomes 1-22) in which a trait manifests in heterozygotes. In the context of medical genetics, an autosomal dominant disorder is caused when a single copy of the mutant allele is present. Males and females are affected equally, and can both transmit the disorder with a risk of 50% for each child of inheriting the mutant allele. Evidence: TAS. (OMIM:616361)
- Slowly progressive (HP:0003677): Applies to a disease manifestation that only slowly increases in scope or severity over the course of time. Evidence: TAS. (OMIM:616361)